- Inflammation of the large intestine (HP:0002037): Inflammation, or an inflammatory state in the large intestine. Evidence: IEA. (OMIM:612278)
This phenotype is associated with the disease inflammatory bowel disease 19 (OMIM:612278).